Phenotypes associated with the disease Opitz GBBB syndrome (ORPHA:2745):
- Hypertelorism (HP:0000316): Interpupillary distance more than 2 SD above the mean (alternatively, the appearance of an increased interpupillary distance or widely spaced eyes). Evidence: TAS. Frequency: Very frequent (HP:0040281). (ORPHA:2745)
- Long philtrum (HP:0000343): Distance between nasal base and midline upper lip vermilion border more than 2 SD above the mean. Alternatively, an apparently increased distance between nasal base and midline upper lip vermilion border. Evidence: TAS. Frequency: Very frequent (HP:0040281). (ORPHA:2745)
- Wide nasal bridge (HP:0000431): Increased breadth of the nasal bridge (and with it, the nasal root). Evidence: TAS. Frequency: Very frequent (HP:0040281). (ORPHA:2745)
- Prominent forehead (HP:0011220): Forward prominence of the entire forehead, due to protrusion of the frontal bone. Evidence: TAS. Frequency: Very frequent (HP:0040281). (ORPHA:2745)
- Hypospadias (HP:0000047): Abnormal position of urethral meatus on the ventral penile shaft (underside) characterized by displacement of the urethral meatus from the tip of the glans penis to the ventral surface of the penis, scrotum, or perineum. Evidence: TAS. Frequency: Frequent (HP:0040282). (ORPHA:2745)
- Cleft palate (HP:0000175): Cleft palate is a developmental defect of the palate resulting from a failure of fusion of the palatine processes and manifesting as a separation of the roof of the mouth (soft and hard palate). Evidence: TAS. Frequency: Frequent (HP:0040282). (ORPHA:2745)
- Widow's peak (HP:0000349): Frontal hairline with bilateral arcs to a low point in the midline of the forehead. Evidence: TAS. Frequency: Frequent (HP:0040282). (ORPHA:2745)
- Anteverted nares (HP:0000463): Anteriorly-facing nostrils viewed with the head in the Frankfurt horizontal and the eyes of the observer level with the eyes of the subject. This gives the appearance of an upturned nose (upturned nasal tip). Evidence: TAS. Frequency: Frequent (HP:0040282). (ORPHA:2745)
- Telecanthus (HP:0000506): Distance between the inner canthi more than two standard deviations above the mean (objective); or, apparently increased distance between the inner canthi. Evidence: TAS. Frequency: Frequent (HP:0040282). (ORPHA:2745)
- Ptosis (HP:0000508): The upper eyelid margin is positioned 3 mm or more lower than usual and covers the superior portion of the iris (objective); or, the upper lid margin obscures at least part of the pupil (subjective). Evidence: TAS. Frequency: Frequent (HP:0040282). (ORPHA:2745)
- Short attention span (HP:0000736): Reduced attention span characterized by distractibility and impulsivity. Evidence: TAS. Frequency: Frequent (HP:0040282). (ORPHA:2745)
- Intellectual disability (HP:0001249): The term intellectual disability or intellectual developmental disorder is used to describe significantly sub-average intellectual and adaptive functioning based on clinical assessment and as measured by individually administered, appropriately normed, standardized and validated tests of intellectual functioning and adaptive behavior, with onset during the developmental period from infancy through adolescence. Evidence: TAS. Frequency: Frequent (HP:0040282). (ORPHA:2745)
- Abnormal corpus callosum morphology (HP:0001273): Abnormality of the corpus callosum. Evidence: TAS. Frequency: Frequent (HP:0040282). (ORPHA:2745)
- Specific learning disability (HP:0001328): Impairment of certain skills such as reading or writing, coordination, self-control, or attention that interfere with the ability to learn. The impairment is not related to a global deficiency of intelligence. Evidence: TAS. Frequency: Frequent (HP:0040282). (ORPHA:2745)
- Abnormal facial shape (HP:0001999): An abnormal morphology (form) of the face or its components. Evidence: TAS. Frequency: Frequent (HP:0040282). (ORPHA:2745)
- Ventriculomegaly (HP:0002119): An increase in size of the ventricular system of the brain. Evidence: TAS. Frequency: Frequent (HP:0040282). (ORPHA:2745)
- Short stature (HP:0004322): A height below that which is expected according to age and gender norms. Although there is no universally accepted definition of short stature, many refer to "short stature" as height more than 2 standard deviations below the mean for age and gender (or below the 3rd percentile for age and gender dependent norms). Evidence: TAS. Frequency: Frequent (HP:0040282). (ORPHA:2745)
- Laryngeal cleft (HP:0008751): Presence of a gap in the posterior laryngotracheal wall with a continuity between the larynx and the esophagus. Evidence: TAS. Frequency: Frequent (HP:0040282). (ORPHA:2745)
- Neurodevelopmental delay (HP:0012758): Neurodevelopmental delay (NDD) refers to delays in the maturation of the brain and central nervous system; infants and young children with NDD may experience delays in the development of one or more skills including gross motor abilities, fine-motor coordination, language abilities and ability to solve increasingly complex problems. Evidence: TAS. Frequency: Frequent (HP:0040282). (ORPHA:2745)
- Cleft lip (HP:0410030): A gap in the lip or lips. Evidence: TAS. Frequency: Frequent (HP:0040282). (ORPHA:2745)
- Inguinal hernia (HP:0000023): Protrusion of the contents of the abdominal cavity through the inguinal canal. Evidence: TAS. Frequency: Occasional (HP:0040283). (ORPHA:2745)
- Cryptorchidism (HP:0000028): Testis in inguinal canal. That is, absence of one or both testes from the scrotum owing to failure of the testis or testes to descend through the inguinal canal to the scrotum. Evidence: TAS. Frequency: Occasional (HP:0040283). (ORPHA:2745)
- Bifid scrotum (HP:0000048): Midline indentation or cleft of the scrotum. Evidence: TAS. Frequency: Occasional (HP:0040283). (ORPHA:2745)
- Shawl scrotum (HP:0000049): Superior margin of the scrotum superior to the base of the penis. Evidence: TAS. Frequency: Occasional (HP:0040283). (ORPHA:2745)
- Vesicoureteral reflux (HP:0000076): Abnormal (retrograde) movement of urine from the bladder into ureters or kidneys related to inadequacy of the valvular mechanism at the ureterovesicular junction or other causes. Evidence: TAS. Frequency: Occasional (HP:0040283). (ORPHA:2745)
- Abnormality of the urinary system (HP:0000079): An abnormality of the urinary system. Evidence: TAS. Frequency: Occasional (HP:0040283). (ORPHA:2745)
- Abnormality of the genitourinary system (HP:0000119): The presence of any abnormality of the genitourinary system. Evidence: TAS. Frequency: Occasional (HP:0040283). (ORPHA:2745)
- Hydronephrosis (HP:0000126): Severe distention of the kidney with dilation of the renal pelvis and calices. Evidence: TAS. Frequency: Occasional (HP:0040283). (ORPHA:2745)
- High palate (HP:0000218): Height of the palate more than 2 SD above the mean (objective) or palatal height at the level of the first permanent molar more than twice the height of the teeth (subjective). Evidence: TAS. Frequency: Occasional (HP:0040283). (ORPHA:2745)
- Large fontanelles (HP:0000239): In newborns, the two frontal bones, two parietal bones, and one occipital bone are joined by fibrous sutures, which form a small posterior fontanelle, and a larger, diamond-shaped anterior fontanelle. These regions allow for the skull to pass the birth canal and for later growth. The fontanelles gradually ossify, whereby the posterior fontanelle usually closes by eight weeks and the anterior fontanelle by the 9th to 16th month of age. Large fontanelles are diagnosed if the fontanelles are larger than age-dependent norms. Evidence: TAS. Frequency: Occasional (HP:0040283). (ORPHA:2745)
- Microcephaly (HP:0000252): Head circumference below 2 standard deviations below the mean for age and gender. Evidence: TAS. Frequency: Occasional (HP:0040283). (ORPHA:2745)
- Micrognathia (HP:0000347): Developmental hypoplasia of the mandible. Evidence: TAS. Frequency: Occasional (HP:0040283). (ORPHA:2745)
- Posteriorly rotated ears (HP:0000358): A type of abnormal location of the ears in which the position of the ears is characterized by posterior rotation (the superior part of the ears is rotated towards the back of the head, and the inferior part of the ears towards the front). Evidence: TAS. Frequency: Occasional (HP:0040283). (ORPHA:2745)
- Hearing impairment (HP:0000365): A decreased magnitude of the sensory perception of sound. Evidence: TAS. Frequency: Occasional (HP:0040283). (ORPHA:2745)
- Low-set ears (HP:0000369): Upper insertion of the ear to the scalp below an imaginary horizontal line drawn between the inner canthi of the eye and extending posteriorly to the ear. Evidence: TAS. Frequency: Occasional (HP:0040283). (ORPHA:2745)
- Downslanted palpebral fissures (HP:0000494): The palpebral fissure inclination is more than two standard deviations below the mean. Evidence: TAS. Frequency: Occasional (HP:0040283). (ORPHA:2745)
- Autistic behavior (HP:0000729): Persistent deficits in social interaction and communication and interaction as well as a markedly restricted repertoire of activity and interest as well as repetitive patterns of behavior. Evidence: TAS. Frequency: Occasional (HP:0040283). (ORPHA:2745)
- Congenital diaphragmatic hernia (HP:0000776): The presence of a hernia of the diaphragm present at birth. Evidence: TAS. Frequency: Occasional (HP:0040283). (ORPHA:2745)
- Agenesis of corpus callosum (HP:0001274): Absence of the corpus callosum as a result of the failure of the corpus callosum to develop, which can be the result of a failure in any one of the multiple steps of callosal development including cellular proliferation and migration, axonal growth or glial patterning at the midline. Evidence: TAS. Frequency: Occasional (HP:0040283). (ORPHA:2745)
- Dandy-Walker malformation (HP:0001305): A congenital brain malformation typically characterized by incomplete formation of the cerebellar vermis, dilation of the fourth ventricle, and enlargement of the posterior fossa. In layman's terms, Dandy Walker malformation is a cyst in the cerebellum (typically symmetrical) that is involved with the fourth ventricle. This may interfere with the ability to drain cerebrospinal fluid from the brain, resulting in hydrocephalus. Dandy Walker cysts are formed during early embryonic development, while the brain forms. The cyst in the cerebellum typically has several blood vessels running through it connecting to the brain, thereby prohibiting surgical removal. Evidence: TAS. Frequency: Occasional (HP:0040283). (ORPHA:2745)
- Craniosynostosis (HP:0001363): Craniosynostosis refers to the premature closure of the cranial sutures. Primary craniosynostosis refers to the closure of one or more sutures due to abnormalities in skull development, and secondary craniosynostosis results from failure of brain growth. Evidence: TAS. Frequency: Occasional (HP:0040283). (ORPHA:2745)
- Umbilical hernia (HP:0001537): Protrusion of abdominal contents through a defect in the abdominal wall musculature around the umbilicus. Skin and subcutaneous tissue overlie the defect. Evidence: TAS. Frequency: Occasional (HP:0040283). (ORPHA:2745)
- Omphalocele (HP:0001539): A midline anterior incomplete closure of the abdominal wall in which there is herniation of the abdominal viscera into the base of the abdominal cord. Evidence: TAS. Frequency: Occasional (HP:0040283). (ORPHA:2745)
- Abnormal heart morphology (HP:0001627): Any structural anomaly of the heart. Evidence: TAS. Frequency: Occasional (HP:0040283). (ORPHA:2745)
- Ventricular septal defect (HP:0001629): A hole between the two bottom chambers (ventricles) of the heart. The defect is centered around the most superior aspect of the ventricular septum. Evidence: TAS. Frequency: Occasional (HP:0040283). (ORPHA:2745)
- Atrial septal defect (HP:0001631): Atrial septal defect (ASD) is a congenital abnormality of the interatrial septum that enables blood flow between the left and right atria via the interatrial septum. Evidence: TAS. Frequency: Occasional (HP:0040283). (ORPHA:2745)
- Patent ductus arteriosus (HP:0001643): In utero, the ductus arteriosus (DA) serves to divert ventricular output away from the lungs and toward the placenta by connecting the main pulmonary artery to the descending aorta. A patent ductus arteriosus (PDA) in the first 3 days of life is a physiologic shunt in healthy term and preterm newborn infants, and normally is substantially closed within about 24 hours after bith and completely closed after about three weeks. Failure of physiologcal closure is referred to a persistent or patent ductus arteriosus (PDA). Depending on the degree of left-to-right shunting, PDA can have clinical consequences. Evidence: TAS. Frequency: Occasional (HP:0040283). (ORPHA:2745)
- Patent foramen ovale (HP:0001655): Failure of the foramen ovale to seal postnatally, leaving a potential conduit between the left and right cardiac atria. Evidence: TAS. Frequency: Occasional (HP:0040283). (ORPHA:2745)
- Coarctation of aorta (HP:0001680): Coarctation of the aorta is a narrowing or constriction of a segment of the aorta. Evidence: TAS. Frequency: Occasional (HP:0040283). (ORPHA:2745)
- Dysphagia (HP:0002015): Difficulty in swallowing. Evidence: TAS. Frequency: Occasional (HP:0040283). (ORPHA:2745)
- Anal atresia (HP:0002023): Congenital absence of the anus, i.e., the opening at the bottom end of the intestinal tract. Evidence: TAS. Frequency: Occasional (HP:0040283). (ORPHA:2745)
- Hypoplasia of the corpus callosum (HP:0002079): Underdevelopment of the corpus callosum. Evidence: TAS. Frequency: Occasional (HP:0040283). (ORPHA:2745)
- Recurrent aspiration pneumonia (HP:0002100): Increased susceptibility to aspiration pneumonia, defined as pneumonia due to breathing in foreign material, as manifested by a medical history of repeated episodes of aspiration pneumonia. Evidence: TAS. Frequency: Occasional (HP:0040283). (ORPHA:2745)
- Poor speech (HP:0002465). Evidence: TAS. Frequency: Occasional (HP:0040283). (ORPHA:2745)
- Tracheoesophageal fistula (HP:0002575): An abnormal connection (fistula) between the esophagus and the trachea. Evidence: TAS. Frequency: Occasional (HP:0040283). (ORPHA:2745)
- Aortic root aneurysm (HP:0002616): An abnormal localized widening (dilatation) of the aortic root. Evidence: TAS. Frequency: Occasional (HP:0040283). (ORPHA:2745)
- Ectopic anus (HP:0004397): Abnormal displacement or malposition of the anus. Evidence: TAS. Frequency: Occasional (HP:0040283). (ORPHA:2745)
- Preauricular pit (HP:0004467): Small indentation anterior to the insertion of the ear. Evidence: TAS. Frequency: Occasional (HP:0040283). (ORPHA:2745)
- Persistent left superior vena cava (HP:0005301): A rare congenital vascular anomaly that results when the left superior cardinal vein caudal to the innominate vein fails to regress. Evidence: TAS. Frequency: Occasional (HP:0040283). (ORPHA:2745)
- Prominent metopic ridge (HP:0005487): Vertical bony ridge positioned in the midline of the forehead. Evidence: TAS. Frequency: Occasional (HP:0040283). (ORPHA:2745)
- Aplasia/Hypoplasia of the cerebellar vermis (HP:0006817): Absence or underdevelopment of the vermis of cerebellum. Evidence: TAS. Frequency: Occasional (HP:0040283). (ORPHA:2745)
- Feeding difficulties in infancy (HP:0008872): Impaired feeding performance of an infant as manifested by difficulties such as weak and ineffective sucking, brief bursts of sucking, and falling asleep during sucking. There may be difficulties with chewing or maintaining attention. Evidence: TAS. Frequency: Occasional (HP:0040283). (ORPHA:2745)
- Stridor (HP:0010307): Stridor is a high pitched sound resulting from turbulent air flow in the upper airway. Evidence: TAS. Frequency: Occasional (HP:0040283). (ORPHA:2745)
- Abnormal brain morphology (HP:0012443): A structural abnormality of the brain, which has as its parts the forebrain, midbrain, and hindbrain. Evidence: TAS. Frequency: Occasional (HP:0040283). (ORPHA:2745)
- Delayed ability to walk (HP:0031936): A failure to achieve the ability to walk at an appropriate developmental stage. Most children learn to walk in a series of stages, and learn to walk short distances independently between 12 and 15 months. Evidence: TAS. Frequency: Occasional (HP:0040283). (ORPHA:2745)
- Enlarged ovaries (HP:0100879). Evidence: TAS. Frequency: Occasional (HP:0040283). (ORPHA:2745)
- Strabismus (HP:0000486): A misalignment of the eyes so that the visual axes deviate from bifoveal fixation. The classification of strabismus may be based on a number of features including the relative position of the eyes, whether the deviation is latent or manifest, intermittent or constant, concomitant or otherwise and according to the age of onset and the relevance of any associated refractive error. Evidence: TAS. Frequency: Very rare (HP:0040284). (ORPHA:2745)
- Abnormality of refraction (HP:0000539): An abnormality in the process of focusing of light by the eye in order to produce a sharp image on the retina. Evidence: TAS. Frequency: Very rare (HP:0040284). (ORPHA:2745)
- Hypodontia (HP:0000668): The absence of five or less teeth from the normal series by a failure to develop. Evidence: TAS. Frequency: Very rare (HP:0040284). (ORPHA:2745)
- Natal tooth (HP:0000695): A tooth present at birth or erupting within the first month of life. Evidence: TAS. Frequency: Very rare (HP:0040284). (ORPHA:2745)
- Bicornuate uterus (HP:0000813): The presence of a bicornuate uterus. Evidence: TAS. Frequency: Very rare (HP:0040284). (ORPHA:2745)
- Tracheomalacia (HP:0002779). Evidence: TAS. Frequency: Very rare (HP:0040284). (ORPHA:2745)
- Vertebral segmentation defect (HP:0003422): An abnormality related to a defect of vertebral separation during development. Evidence: TAS. Frequency: Very rare (HP:0040284). (ORPHA:2745)
- Ankyloglossia (HP:0010296): Short or anteriorly attached lingual frenulum, associated with limited mobility of the tongue. Evidence: TAS. Frequency: Very rare (HP:0040284). (ORPHA:2745)
- Thyroglossal cyst (HP:0010518): An abnormality of the thyroid gland owing to the presence of a fibrous cyst resulting from the persistence of the thyroglossal duct. Evidence: TAS. Frequency: Very rare (HP:0040284). (ORPHA:2745)